- Increased circulating IgE concentration (HP:0003212): An abnormally increased overall level of immunoglobulin E in blood. Evidence: PCS. (PMID:17088085)
- Recurrent mycobacterial infections (HP:0011274): Increased susceptibility to mycobacterial infections as manifested by recurrent episodes of mycobacterial infection. Evidence: PCS. (PMID:17088085)
- Autosomal recessive inheritance (HP:0000007): A mode of inheritance that is observed for traits related to a gene encoded on one of the autosomes (i.e., the human chromosomes 1-22) in which a trait manifests in individuals with two pathogenic alleles, either homozygotes (two copies of the same mutant allele) or compound heterozygotes (whereby each copy of a gene has a distinct mutant allele). Evidence: PCS. (PMID:17088085)
- Recurrent viral infections (HP:0004429): Increased susceptibility to viral infections as manifested by recurrent episodes of viral infection. Evidence: PCS. (PMID:17088085)
- Recurrent respiratory infections (HP:0002205): An increased susceptibility to respiratory infections as manifested by a history of recurrent respiratory infections. Evidence: TAS. (OMIM:611521)
- Recurrent fungal infections (HP:0002841): Increased susceptibility to fungal infections as manifested by multiple episodes of fungal infection. Evidence: PCS. (PMID:17088085)
- Immunodeficiency (HP:0002721): Failure of the immune system to protect the body adequately from infection, due to the absence or insufficiency of some component process or substance. Evidence: TAS. (OMIM:611521)
These phenotypes are associated with the disease immunodeficiency 35 (OMIM:611521).